Phenotypes associated with the disease spermatogenic failure 17 (OMIM:617214):
- Male infertility (HP:0003251). Evidence: PCS. Frequency: 2/2. (PMID:26721930)
- Young adult onset (HP:0011462): Onset of disease at the age of between 16 and 40 years. Evidence: PCS. Frequency: 2/2. (PMID:26721930)
- Autosomal recessive inheritance (HP:0000007): A mode of inheritance that is observed for traits related to a gene encoded on one of the autosomes (i.e., the human chromosomes 1-22) in which a trait manifests in individuals with two pathogenic alleles, either homozygotes (two copies of the same mutant allele) or compound heterozygotes (whereby each copy of a gene has a distinct mutant allele). Evidence: PCS. (PMID:26721930)